Phenotypes associated with the disease Enthesitis-related juvenile idiopathic arthritis (ORPHA:85438):
- Oligoarthritis (HP:0040313): A type of arthritis that affects up to four joints in the first six months of disease. Evidence: TAS. Frequency: Frequent (HP:0040282). (ORPHA:85438)
- Abnormal fascia morphology (HP:0100536): An abnormality of fascia. Evidence: TAS. Frequency: Frequent (HP:0040282). (ORPHA:85438)
- Abnormal lumbar spine morphology (HP:0100712): Any structural abnormality of the lumbar vertebral column. Evidence: TAS. Frequency: Frequent (HP:0040282). (ORPHA:85438)
- Abnormal heart morphology (HP:0001627): Any structural anomaly of the heart. Evidence: TAS. Frequency: Occasional (HP:0040283). (ORPHA:85438)
- Abnormal foot morphology (HP:0001760): An abnormality of the skeleton of foot. Evidence: TAS. Frequency: Occasional (HP:0040283). (ORPHA:85438)
- Abnormal metatarsal morphology (HP:0001832): Abnormalities of the metatarsal bones (i.e. of five tubular bones located between the tarsal bones of the hind- and mid-foot and the phalanges of the toes). Evidence: TAS. Frequency: Occasional (HP:0040283). (ORPHA:85438)
- Abnormality of the wrist (HP:0003019): Abnormality of the wrist, the structure connecting the hand and the forearm. Evidence: TAS. Frequency: Occasional (HP:0040283). (ORPHA:85438)
- Abnormal shoulder morphology (HP:0003043): An abnormality of the shoulder, which is defined as the structures surrounding the shoulder joint where the humerus attaches to the scapula. Evidence: TAS. Frequency: Occasional (HP:0040283). (ORPHA:85438)
- Abnormality of the cervical spine (HP:0003319): Any abnormality of the cervical vertebral column. Evidence: TAS. Frequency: Occasional (HP:0040283). (ORPHA:85438)
- Arthritis (HP:0001369): Inflammation of a joint. Evidence: TAS. Frequency: Very frequent (HP:0040281). (ORPHA:85438)
- Arthralgia (HP:0002829): Joint pain. Evidence: TAS. Frequency: Very frequent (HP:0040281). (ORPHA:85438)
- Enthesitis (HP:0100686). Evidence: TAS. Frequency: Very frequent (HP:0040281). (ORPHA:85438)
- Abnormality of the vertebral column (HP:0000925): Any abnormality of the vertebral column. Evidence: TAS. Frequency: Frequent (HP:0040282). (ORPHA:85438)
- Abnormal hip joint morphology (HP:0001384): An abnormality of the hip joint. Evidence: TAS. Frequency: Frequent (HP:0040282). (ORPHA:85438)
- Abnormality of the ankle (HP:0003028): An anomaly of the joint that connects the foot with the leg. Evidence: TAS. Frequency: Frequent (HP:0040282). (ORPHA:85438)
- Back pain (HP:0003418): An unpleasant sensation characterized by physical discomfort (such as pricking, throbbing, or aching) localized to the back. Evidence: TAS. Frequency: Frequent (HP:0040282). (ORPHA:85438)
- Thickened Achilles tendon (HP:0004690): An abnormal thickening of the Achilles tendon. Evidence: TAS. Frequency: Frequent (HP:0040282). (ORPHA:85438)
- Knee osteoarthritis (HP:0005086). Evidence: TAS. Frequency: Frequent (HP:0040282). (ORPHA:85438)
- Abnormality of the calcaneus (HP:0008364): An abnormality of the calcaneus, also known as the heel bone, one of the or heel bone, one of the components of the tarsus of the foot which make up the heel. Evidence: TAS. Frequency: Frequent (HP:0040282). (ORPHA:85438)
- Hip osteoarthritis (HP:0008843). Evidence: TAS. Frequency: Frequent (HP:0040282). (ORPHA:85438)
- Sacroiliac arthritis (HP:0012317): Inflammation of the sacroiliac joint, generally accompanied by lower back pain. Evidence: TAS. Frequency: Frequent (HP:0040282). (ORPHA:85438)
- Abnormal femoral neck/head morphology (HP:0003366). Evidence: TAS. Frequency: Occasional (HP:0040283). (ORPHA:85438)
- Limited mobility of proximal interphalangeal joint (HP:0006217). Evidence: TAS. Frequency: Occasional (HP:0040283). (ORPHA:85438)
- Nongranulomatous uveitis (HP:0007813): A form of uveitis that is not associated with the formation of granulomas. Evidence: TAS. Frequency: Occasional (HP:0040283). (ORPHA:85438)
- Abnormality of the elbow (HP:0009811): An anomaly of the joint that connects the upper and the lower arm. Evidence: TAS. Frequency: Occasional (HP:0040283). (ORPHA:85438)
- Abnormal skeletal morphology (HP:0011842): An abnormality of the form, structure, or size of the skeletal system. Evidence: TAS. Frequency: Occasional (HP:0040283). (ORPHA:85438)
- Abnormal metacarpophalangeal joint morphology (HP:0011911): An anomaly of a metacarpophalangeal joint. Evidence: TAS. Frequency: Occasional (HP:0040283). (ORPHA:85438)
- Anterior uveitis (HP:0012122): Inflammation of the uveal tract in which the primary site of inflammation is the anterior chamber. Evidence: TAS. Frequency: Occasional (HP:0040283). (ORPHA:85438)
- Finger dactylitis (HP:0031090): Fingers appear swollen and plump owing to inflammation of the complete finger. Evidence: TAS. Frequency: Occasional (HP:0040283). (ORPHA:85438)
- Abnormal thoracic spine morphology (HP:0100711): An abnormality of the thoracic vertebral column. Evidence: TAS. Frequency: Occasional (HP:0040283). (ORPHA:85438)
- IgA deposition in the glomerulus (HP:0000794): The presence of immunoglobulin A deposits in the glomerulus. Evidence: TAS. Frequency: Very rare (HP:0040284). (ORPHA:85438)
- Mitral valve prolapse (HP:0001634): One or both of the leaflets (cusps) of the mitral valve bulges back into the left atrium upon contraction of the left ventricle. Evidence: TAS. Frequency: Very rare (HP:0040284). (ORPHA:85438)
- Aortic regurgitation (HP:0001659): An insufficiency of the aortic valve, leading to regurgitation (backward flow) of blood from the aorta into the left ventricle. Evidence: TAS. Frequency: Very rare (HP:0040284). (ORPHA:85438)
- Dilatation of the ventricular cavity (HP:0006698): A localized outpouching of ventricular cavity that is generally associated with dyskinesia and paradoxical expansion during systole. Evidence: TAS. Frequency: Very rare (HP:0040284). (ORPHA:85438)